Phenotypes associated with the disease Obesity, susceptibility to, BMIQ18 (OMIM:615457):
- Obesity (HP:0001513): Accumulation of substantial excess body fat. Evidence: PCS. (PMID:23869016)
- Autosomal dominant inheritance (HP:0000006): A mode of inheritance that is observed for traits related to a gene encoded on one of the autosomes (i.e., the human chromosomes 1-22) in which a trait manifests in heterozygotes. In the context of medical genetics, an autosomal dominant disorder is caused when a single copy of the mutant allele is present. Males and females are affected equally, and can both transmit the disorder with a risk of 50% for each child of inheriting the mutant allele. Evidence: PCS. (PMID:23869016)